Phenotypes associated with the disease anemia, nonspherocytic hemolytic, associated with abnormality of red cell membrane (OMIM:206300, an entry in Online Mendelian Inheritance in Man):
- Abnormality of metabolism/homeostasis (HP:0001939, a Human Phenotype Ontology term). Evidence: IEA. (OMIM:206300)
- Autosomal recessive inheritance (HP:0000007, a Human Phenotype Ontology term): A mode of inheritance that is observed for traits related to a gene encoded on one of the autosomes (i.e., the human chromosomes 1-22) in which a trait manifests in individuals with two pathogenic alleles, either homozygotes (two copies of the same mutant allele) or compound heterozygotes (whereby each copy of a gene has a distinct mutant allele). Evidence: IEA. (OMIM:206300)
- Nonspherocytic hemolytic anemia (HP:0001930, a Human Phenotype Ontology term). Evidence: IEA. (OMIM:206300)